- Schizophrenia (HP:0100753): A mental disorder characterized by a disintegration of thought processes and emotional responsiveness. It most commonly manifests as auditory hallucinations, paranoid or bizarre delusions, or disorganized speech and thinking. It is accompanied by significant social or occupational dysfunction. The onset of symptoms typically occurs in young adulthood, with a global lifetime prevalence of about 1%. This term is not a helpful parent term to describe abnormal experiences. Evidence: TAS. (OMIM:600511)
- Abnormality of the nervous system (HP:0000707): An abnormality of the nervous system. Evidence: IEA. (OMIM:600511)
- Autosomal dominant inheritance (HP:0000006): A mode of inheritance that is observed for traits related to a gene encoded on one of the autosomes (i.e., the human chromosomes 1-22) in which a trait manifests in heterozygotes. In the context of medical genetics, an autosomal dominant disorder is caused when a single copy of the mutant allele is present. Males and females are affected equally, and can both transmit the disorder with a risk of 50% for each child of inheriting the mutant allele. Evidence: TAS. (OMIM:600511)
These phenotypes are associated with the disease schizophrenia 3 (OMIM:600511).